Phenotypes associated with the disease advance sleep phase syndrome, familial, 4 (OMIM:620015):
- Early chronotype (HP:0031873): A tendency towards rising very early in the morning and going to bed early in the evening. Evidence: PCS. Frequency: 2/2. (PMID:31138685)
- Autosomal dominant inheritance (HP:0000006): A mode of inheritance that is observed for traits related to a gene encoded on one of the autosomes (i.e., the human chromosomes 1-22) in which a trait manifests in heterozygotes. In the context of medical genetics, an autosomal dominant disorder is caused when a single copy of the mutant allele is present. Males and females are affected equally, and can both transmit the disorder with a risk of 50% for each child of inheriting the mutant allele. Evidence: PCS. (PMID:31138685)